- Broad-based gait (HP:0002136): An abnormal gait pattern in which persons stand and walk with their feet spaced widely apart. This is often a component of cerebellar ataxia. Evidence: PCS. Frequency: 6/6. (PMID:27863452)
- Microcephaly (HP:0000252): Head circumference below 2 standard deviations below the mean for age and gender. Evidence: PCS. Frequency: 0/6. (PMID:27863452)
- Generalized muscle weakness (HP:0003324): Generalized weakness or decreased strength of the muscles, affecting both distal and proximal musculature. Evidence: PCS. Frequency: 6/6. (PMID:27863452)
- Truncal ataxia (HP:0002078): Truncal ataxia is a sign of ataxia characterized by instability of the trunk. It usually occurs during sitting. Evidence: PCS. Frequency: 6/6. (PMID:27863452)
- Delayed ability to walk (HP:0031936): A failure to achieve the ability to walk at an appropriate developmental stage. Most children learn to walk in a series of stages, and learn to walk short distances independently between 12 and 15 months. Evidence: PCS. Frequency: 6/6. (PMID:27863452)
- Cerebellar hypoplasia (HP:0001321): Cerebellar hypoplasia is a descriptive term implying a cerebellum with a reduced volume, but a normal shape and is stable over time. Evidence: PCS. Frequency: 5/5. (PMID:27863452)
- Febrile seizure (within the age range of 3 months to 6 years) (HP:0002373): A febrile seizure is any type of seizure (most often a generalized tonic-clonic seizure) occurring with fever (at least 38 degrees Celsius) but in the absence of central nervous system infection, severe metabolic disturbance or other alternative precipitant in children between the ages of 3 months and 6 years. Evidence: PCS. Frequency: 3/6. (PMID:27863452)
- Focal impaired awareness seizure (HP:0002384): Focal impaired awareness seizure (or focal seizure with impaired or lost awareness) is a type of focal-onset seizure characterized by some degree (which may be partial) of impairment of the person's awareness of themselves or their surroundings at any point during the seizure. Evidence: PCS. Frequency: 1/6. (PMID:27863452)
- Gait ataxia (HP:0002066): A type of ataxia characterized by the impairment of the ability to coordinate the movements required for normal walking. Gait ataxia is characteirzed by a wide-based staggering gait with a tendency to fall. Evidence: PCS. Frequency: 6/6. (PMID:27863452)
- Dysarthria (HP:0001260): Dysarthric speech is a general description referring to a neurological speech disorder characterized by poor articulation. Depending on the involved neurological structures, dysarthria may be further classified as spastic, flaccid, ataxic, hyperkinetic and hypokinetic, or mixed. Evidence: PCS. Frequency: 5/6. (PMID:27863452)
- Dilated fourth ventricle (HP:0002198): An abnormal dilatation of the fourth cerebral ventricle. Evidence: PCS. Frequency: 5/5. (PMID:27863452)
- Hypotonia (HP:0001252): Hypotonia is an abnormally low muscle tone (the amount of tension or resistance to movement in a muscle). Even when relaxed, muscles have a continuous and passive partial contraction which provides some resistance to passive stretching. Hypotonia thus manifests as diminished resistance to passive stretching. Hypotonia is not the same as muscle weakness, although the two conditions can co-exist. Evidence: PCS. Frequency: 5/6. (PMID:27863452)
- Infantile onset (HP:0003593): Onset of signs or symptoms of disease between 28 days to one year of life. Evidence: PCS. Frequency: 6/6. (PMID:27863452)
- Arrhythmia (HP:0011675): Any cardiac rhythm other than the normal sinus rhythm. Such a rhythm may be either of sinus or ectopic origin and either regular or irregular. An arrhythmia may be due to a disturbance in impulse formation or conduction or both. Evidence: PCS. Frequency: 0/6. (PMID:27863452)
- Gowers sign (HP:0003391): A phenomenon whereby patients are not able to stand up without the use of the hands owing to weakness of the proximal muscles of the lower limbs. Evidence: PCS. Frequency: 0/6. (PMID:27863452)
- Enlarged cisterna magna (HP:0002280): Increase in size of the cisterna magna, one of three principal openings in the subarachnoid space between the arachnoid and pia mater, located between the cerebellum and the dorsal surface of the medulla oblongata. Evidence: PCS. Frequency: 5/5. (PMID:27863452)
- Intention tremor (HP:0002080): A type of kinetic tremor that occurs during target directed movement is called intention tremor. That is, an oscillatory cerebellar ataxia that tends to be absent when the limbs are inactive and during the first part of voluntary movement but worsening as the movement continues and greater precision is required (e.g., in touching a target such as the patient's nose or a physician's finger). Evidence: PCS. Frequency: 6/6. (PMID:27863452)
- Autosomal recessive inheritance (HP:0000007): A mode of inheritance that is observed for traits related to a gene encoded on one of the autosomes (i.e., the human chromosomes 1-22) in which a trait manifests in individuals with two pathogenic alleles, either homozygotes (two copies of the same mutant allele) or compound heterozygotes (whereby each copy of a gene has a distinct mutant allele). Evidence: PCS. (PMID:27863452)
- Reduced visual acuity (HP:0007663). Evidence: PCS. Frequency: 0/6. (PMID:27863452)
- Frequent falls (HP:0002359). Evidence: PCS. Frequency: 6/6. (PMID:27863452)
- Head titubation (HP:0002599): A head tremor of moderate speed (3 to 4 Hz) in the anterior-posterior direction. Evidence: PCS. Frequency: 6/6. (PMID:27863452)
- Simplified gyral pattern (HP:0009879): An abnormality of the cerebral cortex with fewer gyri but with normal cortical thickness. This pattern is usually often associated with congenital microcephaly. Evidence: PCS. Frequency: 0/5. (PMID:27863452)
These phenotypes are associated with the disease spinocerebellar ataxia, autosomal recessive 33 (OMIM:620208).